Phenotypes associated with the disease pachyonychia congenita 1 (OMIM:167200):
- Onychogryphosis (HP:0001805): Onychogryphosis is a disorder of nail plate growth that is clinically characterized by an opaque, yellow-brown thickening of the nail plate with associated gross hyperkeratosis, elongation, and increased curvature. Evidence: IEA. (OMIM:167200)
- Palmoplantar hyperkeratosis (HP:0000972): Abnormal thickening of the skin localized to the palm of the hand and the sole of the foot. Evidence: PCS. Frequency: 1/1. (PMID:7539673)
- Nail dystrophy (HP:0008404): Onychodystrophy (nail dystrophy) refers to nail changes apart from changes of the color (nail dyschromia) and involves partial or complete disruption of the various keratinous layers of the nail plate. Evidence: PCS. Frequency: 1/1. (PMID:7539673)
- Oral leukoplakia (HP:0002745): A thickened white patch on the oral mucosa that cannot be rubbed off. Evidence: PCS. Frequency: 1/1. (PMID:7539673)
- Follicular hyperkeratosis (HP:0007502): A skin condition characterized by excessive development of keratin in hair follicles, resulting in rough, cone-shaped, elevated papules resulting from closure of hair follicles with a white plug of sebum. Evidence: IEA. (OMIM:167200)
- Autosomal dominant inheritance (HP:0000006): A mode of inheritance that is observed for traits related to a gene encoded on one of the autosomes (i.e., the human chromosomes 1-22) in which a trait manifests in heterozygotes. In the context of medical genetics, an autosomal dominant disorder is caused when a single copy of the mutant allele is present. Males and females are affected equally, and can both transmit the disorder with a risk of 50% for each child of inheriting the mutant allele. Evidence: PCS. (PMID:7539673)